- Muscle weakness (HP:0001324): Reduced strength of muscles. Evidence: TAS. Frequency: Occasional (HP:0040283). (ORPHA:139436)
- Arthritis (HP:0001369): Inflammation of a joint. Evidence: TAS. Frequency: Very frequent (HP:0040281). (ORPHA:139436)
- Fever (HP:0001945): Body temperature elevated above the normal range. Evidence: TAS. Frequency: Occasional (HP:0040283). (ORPHA:139436)
- Cachexia (HP:0004326): Severe weight loss, wasting of muscle, loss of appetite, and general debility related to a chronic disease. Evidence: TAS. Frequency: Occasional (HP:0040283). (ORPHA:139436)
- Histiocytosis (HP:0100727): An excessive number of histiocytes (tissue macrophages). Evidence: TAS. Frequency: Very frequent (HP:0040281). (ORPHA:139436)
- Skin nodule (HP:0200036): Morphologically similar to a papule, but greater than either 10mm in both width and depth, and most frequently centered in the dermis or subcutaneous fat. Evidence: TAS. Frequency: Very frequent (HP:0040281). (ORPHA:139436)
These phenotypes are associated with the disease Multicentric reticulohistiocytosis (ORPHA:139436).